Phenotypes associated with the disease proximal 16p11.2 microdeletion syndrome (OMIM:611913):
- Delayed speech and language development (HP:0000750): A degree of language development that is significantly below the norm for a child of a specified age. Evidence: PCS. (PMID:19914906)
- Seizure (HP:0001250): A seizure is an intermittent abnormality of nervous system physiology characterized by a transient occurrence of signs and/or symptoms due to abnormal excessive or synchronous neuronal activity in the brain. Evidence: PCS. Frequency: 5/16. (PMID:19914906)
- Global developmental delay (HP:0001263): A delay in the achievement of motor or mental milestones in the domains of development of a child, including motor skills, speech and language, cognitive skills, and social and emotional skills. This term should only be used to describe children younger than five years of age. Evidence: PCS. (PMID:19914906)
- Hypertelorism (HP:0000316): Interpupillary distance more than 2 SD above the mean (alternatively, the appearance of an increased interpupillary distance or widely spaced eyes). Evidence: PCS. (PMID:19914906)
- Feeding difficulties in infancy (HP:0008872): Impaired feeding performance of an infant as manifested by difficulties such as weak and ineffective sucking, brief bursts of sucking, and falling asleep during sucking. There may be difficulties with chewing or maintaining attention. Evidence: PCS. Frequency: 8/16. (PMID:19914906)
- Midface retrusion (HP:0011800): Posterior positions and/or vertical shortening of the infraorbital and perialar regions, or increased concavity of the face and/or reduced nasolabial angle. Evidence: PCS. (PMID:19914906)
- Broad forehead (HP:0000337): Width of the forehead or distance between the frontotemporales is more than two standard deviations above the mean (objective); or apparently increased distance between the two sides of the forehead. Evidence: PCS. (PMID:19914906)
- Motor delay (HP:0001270): A type of Developmental delay characterized by a delay in acquiring motor skills. Evidence: PCS. Frequency: 8/16. (PMID:19914906)
- Contiguous gene syndrome (HP:0001466): A syndrome caused by the effects of abnormality (typically a deletion or duplication) of 2 or more adjacent genes. Evidence: PCS. (PMID:19914906)
- Macrocephaly (HP:0000256): Occipitofrontal (head) circumference greater than 97th centile compared to appropriate, age matched, sex-matched normal standards. Alternatively, a apparently increased size of the cranium. Evidence: PCS. (PMID:19914906)
- Micrognathia (HP:0000347): Developmental hypoplasia of the mandible. Evidence: PCS. (PMID:19914906)